- Intervertebral disk degeneration (HP:0008419): The presence of degenerative changes of intervertebral disk. Evidence: TAS. Frequency: Occasional (HP:0040283). (ORPHA:3168)
- Large iliac wing (HP:0008818): Increased size of the ilium ala. Evidence: TAS. Frequency: Occasional (HP:0040283). (ORPHA:3168)
- Short finger (HP:0009381): Abnormally short finger associated with developmental hypoplasia. Evidence: TAS. Frequency: Occasional (HP:0040283). (ORPHA:3168)
- Abnormal distal phalanx morphology of finger (HP:0009832): Any anomaly of distal phalanx of finger. Evidence: TAS. Frequency: Occasional (HP:0040283). (ORPHA:3168)
- Abnormal proximal phalanx morphology of the hand (HP:0009834). Evidence: TAS. Frequency: Occasional (HP:0040283). (ORPHA:3168)
- Abnormal morphology of the proximal phalanx of the hallux (HP:0010052): An abnormal shape or form of the proximal phalanx of the big toe. Evidence: TAS. Frequency: Occasional (HP:0040283). (ORPHA:3168)
- Broad thumb (HP:0011304): Increased thumb width without increased dorso-ventral dimension. Evidence: TAS. Frequency: Occasional (HP:0040283). (ORPHA:3168)
- Brachydactyly (HP:0001156): Digits that appear disproportionately short compared to the hand/foot. The word brachydactyly is used here to describe a series distinct patterns of shortened digits (brachydactyly types A-E). This is the sense used here. Evidence: TAS. Frequency: Very frequent (HP:0040281). (ORPHA:3168)
- Pes cavus (HP:0001761): An increase in height of the medial longitudinal arch of the foot that does not flatten on weight bearing (i.e., a distinctly hollow form of the sole of the foot when it is bearing weight). Evidence: TAS. Frequency: Very frequent (HP:0040281). (ORPHA:3168)
- Metatarsus adductus (HP:0001840): The metatarsals are deviated medially (tibially), that is, the bones in the front half of the foot bend or turn in toward the body. Evidence: TAS. Frequency: Frequent (HP:0040282). (ORPHA:3168)
- Scoliosis (HP:0002650): The presence of an abnormal lateral curvature of the spine. Evidence: TAS. Frequency: Frequent (HP:0040282). (ORPHA:3168)
- Flat acetabular roof (HP:0003180): Flattening of the superior part of the acetabulum, which is a cup-shaped cavity at the base of the hipbone into which the ball-shaped head of the femur fits. The acetabular roof thereby appears horizontal rather than arched, as it normally does. Evidence: TAS. Frequency: Frequent (HP:0040282). (ORPHA:3168)
- Short middle phalanx of finger (HP:0005819): Short (hypoplastic) middle phalanx of finger, affecting one or more fingers. Evidence: TAS. Frequency: Frequent (HP:0040282). (ORPHA:3168)
- Aplasia of the middle phalanx of the hand (HP:0010239): Absence of one or more middle phalanx of a finger. Evidence: TAS. Frequency: Frequent (HP:0040282). (ORPHA:3168)
- Camptodactyly (HP:0012385): The distal interphalangeal joint and/or the proximal interphalangeal joint of the fingers or toes cannot be extended to 180 degrees by either active or passive extension. Evidence: TAS. Frequency: Occasional (HP:0040283). (ORPHA:3168)
- Epicanthus (HP:0000286): A fold of skin starting above the medial aspect of the upper eyelid and arching downward to cover, pass in front of and lateral to the medial canthus. Evidence: TAS. Frequency: Occasional (HP:0040283). (ORPHA:3168)
- Oval face (HP:0000300): A face with a rounded and slightly elongated outline. Evidence: TAS. Frequency: Occasional (HP:0040283). (ORPHA:3168)
- Platyspondyly (HP:0000926): A flattened vertebral body shape with reduced distance between the vertebral endplates. Evidence: TAS. Frequency: Occasional (HP:0040283). (ORPHA:3168)
- Slender build (HP:0001533): Asthenic habitus refers to a slender build with long limbs, an angular profile, and prominent muscles or bones. Evidence: TAS. Frequency: Occasional (HP:0040283). (ORPHA:3168)
- Abnormal nail morphology (HP:0001597): Abnormal structure or appearance of the nail. Evidence: TAS. Frequency: Occasional (HP:0040283). (ORPHA:3168)
- Bulbous tips of toes (HP:0001782): An abnormality of the morphology of the toes, such that the tips of the toes are prominent and bulbous. Evidence: TAS. Frequency: Occasional (HP:0040283). (ORPHA:3168)
- Broad metatarsal (HP:0001783): Increased side-to-side width of a metatarsal bone. Evidence: TAS. Frequency: Occasional (HP:0040283). (ORPHA:3168)
- Back pain (HP:0003418): An unpleasant sensation characterized by physical discomfort (such as pricking, throbbing, or aching) localized to the back. Evidence: TAS. Frequency: Occasional (HP:0040283). (ORPHA:3168)
- Abnormal vertebral morphology (HP:0003468): An abnormality of one or more of the vertebrae. Evidence: TAS. Frequency: Occasional (HP:0040283). (ORPHA:3168)
- Large tarsal bones (HP:0004679). Evidence: TAS. Frequency: Occasional (HP:0040283). (ORPHA:3168)
- Chess-pawn distal phalanges (HP:0006170): A morphological abnormality of distal phalanges such that they have the appearance of chess pawns. Evidence: TAS. Frequency: Occasional (HP:0040283). (ORPHA:3168)
These phenotypes are associated with the disease Sillence syndrome (ORPHA:3168).